Phenotypes associated with the disease THIOPURINES, POOR METABOLISM OF, 2 (OMIM:616903):
- Autosomal dominant inheritance (HP:0000006): A mode of inheritance that is observed for traits related to a gene encoded on one of the autosomes (i.e., the human chromosomes 1-22) in which a trait manifests in heterozygotes. In the context of medical genetics, an autosomal dominant disorder is caused when a single copy of the mutant allele is present. Males and females are affected equally, and can both transmit the disorder with a risk of 50% for each child of inheriting the mutant allele. Evidence: TAS. (OMIM:616903)